- Low-set ears (HP:0000369): Upper insertion of the ear to the scalp below an imaginary horizontal line drawn between the inner canthi of the eye and extending posteriorly to the ear. Evidence: TAS. Frequency: Very frequent (HP:0040281). (ORPHA:398173)
- Trichiasis (HP:0001128): Inversion and rubbing of the eyelashes against the globe of the eye. Evidence: TAS. Frequency: Very frequent (HP:0040281). (ORPHA:398173)
- Curved linear dimple below the lower lip (HP:0002055). Evidence: TAS. Frequency: Very frequent (HP:0040281). (ORPHA:398173)
- Distichiasis (HP:0009743): Double rows of eyelashes. Evidence: TAS. Frequency: Very frequent (HP:0040281). (ORPHA:398173)
- Bitemporal forceps marks (HP:0011336): Bilateral temporal scarlike defects, which are said to resemble forceps marks. Evidence: TAS. Frequency: Very frequent (HP:0040281). (ORPHA:398173)
- Sparse eyebrow (HP:0045075): Decreased density/number of eyebrow hairs. Evidence: TAS. Frequency: Very frequent (HP:0040281). (ORPHA:398173)
- Small earlobe (HP:0000385): Reduced volume of the earlobe. Evidence: TAS. Frequency: Frequent (HP:0040282). (ORPHA:398173)
- Horizontal nystagmus (HP:0000666): Nystagmus consisting of horizontal to-and-fro eye movements. Evidence: TAS. Frequency: Frequent (HP:0040282). (ORPHA:398173)
- Generalized hypertrichosis (HP:0004554): Generalized excessive, abnormal hairiness. Evidence: TAS. Frequency: Frequent (HP:0040282). (ORPHA:398173)
- Ectropion of lower eyelids (HP:0007651). Evidence: TAS. Frequency: Frequent (HP:0040282). (ORPHA:398173)
- Abnormal pinna morphology (HP:0000377): An abnormality of the pinna, which is also referred to as the auricle or external ear. Evidence: TAS. Frequency: Occasional (HP:0040283). (ORPHA:398173)
- Absent earlobe (HP:0000387): Absence of fleshy non-cartilaginous tissue inferior to the tragus and incisura. Evidence: TAS. Frequency: Occasional (HP:0040283). (ORPHA:398173)
- Lop ear (HP:0000394): Anterior and inferior folding of the upper portion of the ear that obliterates triangular fossa and scapha. Evidence: TAS. Frequency: Occasional (HP:0040283). (ORPHA:398173)
These phenotypes are associated with the disease Focal facial dermal dysplasia type II (ORPHA:398173).